Phenotypes associated with the disease Kerion celsi (ORPHA:499):
- Recurrent skin infections (HP:0001581): Infections of the skin that happen multiple times. Evidence: TAS. Frequency: Very frequent (HP:0040281). (ORPHA:499)
- Alopecia (HP:0001596): A noncongenital process of hair loss, which may progress to partial or complete baldness. Evidence: TAS. Frequency: Frequent (HP:0040282). (ORPHA:499)
- Fever (HP:0001945): Body temperature elevated above the normal range. Evidence: TAS. Frequency: Frequent (HP:0040282). (ORPHA:499)
- Migraine (HP:0002076): Migraine is a chronic neurological disorder characterized by episodic attacks of headache and associated symptoms. Evidence: TAS. Frequency: Occasional (HP:0040283). (ORPHA:499)
- Lymphadenopathy (HP:0002716): Enlargement (swelling) of a lymph node. Evidence: TAS. Frequency: Frequent (HP:0040282). (ORPHA:499)
- Myalgia (HP:0003326): Pain in muscle. Evidence: TAS. Frequency: Occasional (HP:0040283). (ORPHA:499)
- Inflammatory abnormality of the skin (HP:0011123): The presence of inflammation of the skin. That is, an abnormality of the skin resulting from the local accumulation of fluid, plasma proteins, and leukocytes. Evidence: TAS. Frequency: Very frequent (HP:0040281). (ORPHA:499)
- Recurrent cutaneous abscess formation (HP:0100838): An increased susceptibility to cutaneous abscess formation, as manifested by a medical history of recurrent cutaneous abscesses. Evidence: TAS. Frequency: Very frequent (HP:0040281). (ORPHA:499)